- Trigonocephaly (HP:0000243): Wedge-shaped, or triangular head, with the apex of the triangle at the midline of the forehead and the base of the triangle at the occiput. Evidence: TAS. Frequency: Very frequent (HP:0040281). (ORPHA:3366)
- Metopic synostosis (HP:0011330): Premature fusion of the metopic suture. Evidence: TAS. Frequency: Very frequent (HP:0040281). (ORPHA:3366)
- Prominent supraorbital ridges (HP:0000336): Greater than average forward and/or lateral protrusion of the supraorbital portion of the frontal bones. Evidence: TAS. Frequency: Frequent (HP:0040282). (ORPHA:3366)
- Narrow forehead (HP:0000341): Width of the forehead or distance between the frontotemporales is more than two standard deviations below the mean (objective); or apparently narrow intertemporal region (subjective). Evidence: TAS. Frequency: Frequent (HP:0040282). (ORPHA:3366)
- Wide nasal bridge (HP:0000431): Increased breadth of the nasal bridge (and with it, the nasal root). Evidence: TAS. Frequency: Frequent (HP:0040282). (ORPHA:3366)
- Hypotelorism (HP:0000601): Interpupillary distance less than 2 SD below the mean (alternatively, the appearance of an decreased interpupillary distance or closely spaced eyes). Evidence: TAS. Frequency: Frequent (HP:0040282). (ORPHA:3366)
- Synophrys (HP:0000664): Meeting of the medial eyebrows in the midline. Evidence: TAS. Frequency: Frequent (HP:0040282). (ORPHA:3366)
- Highly arched eyebrow (HP:0002553): Increased height of the central portion of the eyebrow, forming a crescent, semicircular, or inverted U shape. Evidence: TAS. Frequency: Frequent (HP:0040282). (ORPHA:3366)
- Delayed speech and language development (HP:0000750): A degree of language development that is significantly below the norm for a child of a specified age. Evidence: TAS. Frequency: Occasional (HP:0040283). (ORPHA:3366)
- Omphalocele (HP:0001539): A midline anterior incomplete closure of the abdominal wall in which there is herniation of the abdominal viscera into the base of the abdominal cord. Evidence: TAS. Frequency: Occasional (HP:0040283). (ORPHA:3366)
- Papilledema (HP:0001085): Papilledema refers to edema (swelling) of the optic disc secondary to any factor which increases cerebral spinal fluid pressure. Evidence: TAS. Frequency: Very rare (HP:0040284). (ORPHA:3366)
- Increased intracranial pressure (HP:0002516): An increase of the pressure inside the cranium (skull) and thereby in the brain tissue and cerebrospinal fluid. Evidence: TAS. Frequency: Very rare (HP:0040284). (ORPHA:3366)
These phenotypes are associated with the disease Non-syndromic metopic craniosynostosis (ORPHA:3366).